Phenotypes associated with the disease intellectual developmental disorder with autism and dysmorphic facies (OMIM:620021):
- Cleft palate (HP:0000175): Cleft palate is a developmental defect of the palate resulting from a failure of fusion of the palatine processes and manifesting as a separation of the roof of the mouth (soft and hard palate). Evidence: PCS. Frequency: 1/4. (PMID:35227461)
- Astigmatism (HP:0000483): A type of refraction error associated with abnormal curvatures on the anterior and/or posterior surface of the cornea. Evidence: PCS. Frequency: 1/4. (PMID:35227461)
- Echolalia (HP:0010529): Echolalia is the automatic imitative repetition of sounds, words, or phrases in the absence of explicit awareness. The repeated words or phrases are typically odd or used in a non-social manner. These can be words or phrases that the affected individual has heard or invented. Evidence: PCS. Frequency: 1/4. (PMID:35227461)
- Scoliosis (HP:0002650): The presence of an abnormal lateral curvature of the spine. Evidence: PCS. Frequency: 1/4. (PMID:35227461)
- Seizure (HP:0001250): A seizure is an intermittent abnormality of nervous system physiology characterized by a transient occurrence of signs and/or symptoms due to abnormal excessive or synchronous neuronal activity in the brain. Evidence: PCS. Frequency: 2/4. (PMID:35227461)
- Open mouth (HP:0000194): A facial appearance characterized by a permanently or nearly permanently opened mouth. Evidence: PCS. Frequency: 3/4. (PMID:35227461)
- Global developmental delay (HP:0001263): A delay in the achievement of motor or mental milestones in the domains of development of a child, including motor skills, speech and language, cognitive skills, and social and emotional skills. This term should only be used to describe children younger than five years of age. Evidence: PCS. Frequency: 4/4. (PMID:35227461)
- Malar flattening (HP:0000272): Underdevelopment of the malar prominence of the jugal bone (zygomatic bone in mammals), appreciated in profile, frontal view, and/or by palpation. Evidence: PCS. Frequency: 3/4. (PMID:35227461)
- Infantile onset (HP:0003593): Onset of signs or symptoms of disease between 28 days to one year of life. Evidence: PCS. (PMID:35227461)
- Recurrent hand flapping (HP:0100023): A type of repetitive behavior in which the affected individual repeatedly waves the hands and/or arms rhythmically. Evidence: PCS. Frequency: 1/4. (PMID:35227461)
- Autistic behavior (HP:0000729): Persistent deficits in social interaction and communication and interaction as well as a markedly restricted repertoire of activity and interest as well as repetitive patterns of behavior. Evidence: PCS. Frequency: 4/4. (PMID:35227461)
- Hypertelorism (HP:0000316): Interpupillary distance more than 2 SD above the mean (alternatively, the appearance of an increased interpupillary distance or widely spaced eyes). Evidence: PCS. Frequency: 4/4. (PMID:35227461)
- Amblyopia (HP:0000646): Reduced visual acuity that is uncorrectable by lenses in the absence of detectable anatomic defects in the eye or visual pathways. Evidence: PCS. Frequency: 1/4. (PMID:35227461)
- Overlapping toe (HP:0001845): Describes a foot digit resting on the dorsal surface of an adjacent digit when the foot is at rest. Initially clawing may be dynamic and only noticeable on walking. Over time the plantar plate tears, subluxation occurs at the metatarsophalangeal joint (MTPJ), and the deformity becomes permanent. Evidence: PCS. Frequency: 1/4. (PMID:35227461)
- Autosomal recessive inheritance (HP:0000007): A mode of inheritance that is observed for traits related to a gene encoded on one of the autosomes (i.e., the human chromosomes 1-22) in which a trait manifests in individuals with two pathogenic alleles, either homozygotes (two copies of the same mutant allele) or compound heterozygotes (whereby each copy of a gene has a distinct mutant allele). Evidence: PCS. (PMID:35227461)
- Compulsive behaviors (HP:0000722): Behavior that consists of repetitive acts, characterized by the feeling that one "has to" perform them, while being aware that these acts are not in line with one's overall goal. Evidence: PCS. Frequency: 1/4. (PMID:35227461)
- High palate (HP:0000218): Height of the palate more than 2 SD above the mean (objective) or palatal height at the level of the first permanent molar more than twice the height of the teeth (subjective). Evidence: PCS. Frequency: 3/4. (PMID:35227461)
- Attention deficit hyperactivity disorder (HP:0007018): Attention deficit hyperactivity disorder (ADHD) manifests at age 2-3 years or by first grade at the latest. The main symptoms are distractibility, impulsivity, hyperactivity, and often trouble organizing tasks and projects, difficulty going to sleep, and social problems from being aggressive, loud, or impatient. Evidence: PCS. Frequency: 2/4. (PMID:35227461)
- Bilateral ptosis (HP:0001488). Evidence: PCS. Frequency: 1/4. (PMID:35227461)
- Intellectual disability (HP:0001249): The term intellectual disability or intellectual developmental disorder is used to describe significantly sub-average intellectual and adaptive functioning based on clinical assessment and as measured by individually administered, appropriately normed, standardized and validated tests of intellectual functioning and adaptive behavior, with onset during the developmental period from infancy through adolescence. Evidence: PCS. Frequency: 4/4. (PMID:35227461)
- Myopia (HP:0000545): An abnormality of refraction characterized by the ability to see objects nearby clearly, while objects in the distance appear blurry. Evidence: PCS. Frequency: 2/4. (PMID:35227461)
- Low-set ears (HP:0000369): Upper insertion of the ear to the scalp below an imaginary horizontal line drawn between the inner canthi of the eye and extending posteriorly to the ear. Evidence: PCS. Frequency: 1/4. (PMID:35227461)